Phenotypes associated with the disease Kawasaki disease (ORPHA:2331):
- Arthritis (HP:0001369): Inflammation of a joint. Evidence: TAS. Frequency: Frequent (HP:0040282). (ORPHA:2331)
- Abnormal heart valve morphology (HP:0001654): Any structural abnormality of a cardiac valve. Evidence: TAS. Frequency: Frequent (HP:0040282). (ORPHA:2331)
- Pericarditis (HP:0001701): Inflammation of the sac-like covering around the heart (pericardium). Evidence: TAS. Frequency: Frequent (HP:0040282). (ORPHA:2331)
- Thrombocytosis (HP:0001894): Increased numbers of platelets in the peripheral blood. Evidence: TAS. Frequency: Frequent (HP:0040282). (ORPHA:2331)
- Fever (HP:0001945): Body temperature elevated above the normal range. Evidence: TAS. Frequency: Frequent (HP:0040282). (ORPHA:2331)
- Increased total leukocyte count (HP:0001974): An abnormal increase in the number of leukocytes in the blood. Evidence: TAS. Frequency: Frequent (HP:0040282). (ORPHA:2331)
- Diarrhea (HP:0002014): Abnormally increased frequency (usually defined as three or more) loose or watery bowel movements a day. Evidence: TAS. Frequency: Frequent (HP:0040282). (ORPHA:2331)
- Abdominal pain (HP:0002027): An unpleasant sensation characterized by physical discomfort (such as pricking, throbbing, or aching) and perceived to originate in the abdomen. Evidence: TAS. Frequency: Frequent (HP:0040282). (ORPHA:2331)
- Hypoalbuminemia (HP:0003073): The concentration of albumin in the blood circulation is below the lower limit of normal. Evidence: TAS. Frequency: Frequent (HP:0040282). (ORPHA:2331)
- Elevated erythrocyte sedimentation rate (HP:0003565): An increased erythrocyte sedimentation rate (ESR). The ESR is a test that measures the distance that erythrocytes have fallen after one hour in a vertical column of anticoagulated blood under the influence of gravity. The ESR is a nonspecific finding. An elevation may indicate inflammation or may be caused by any condition that elevates fibrinogen. Evidence: TAS. Frequency: Frequent (HP:0040282). (ORPHA:2331)
- Elevated circulating C-reactive protein concentration (HP:0011227): The concentration of C-reactive protein in the blood circulation is above the upper limit of normal. Evidence: TAS. Frequency: Frequent (HP:0040282). (ORPHA:2331)
- Fatigue (HP:0012378): A subjective feeling of tiredness characterized by a lack of energy and motivation. Evidence: TAS. Frequency: Frequent (HP:0040282). (ORPHA:2331)
- Scaling skin on fingertip (HP:0025525): Loss of the outer layer of the epidermis in large, scale-like flakes localized to one or more fingertips. Evidence: TAS. Frequency: Frequent (HP:0040282). (ORPHA:2331)
- Plantar edema (HP:0025537): An abnormal accumulation of fluid beneath the skin on sole of the foot. Evidence: TAS. Frequency: Frequent (HP:0040282). (ORPHA:2331)
- Palmar edema (HP:0025538): An abnormal accumulation of fluid beneath the skin on the palm of the hand. Evidence: TAS. Frequency: Frequent (HP:0040282). (ORPHA:2331)
- Conjunctival hyperemia (HP:0030953): Dilatation of the blood vessels of the conjunctiva leading to a red appearance of the sclera. Evidence: TAS. Frequency: Frequent (HP:0040282). (ORPHA:2331)
- Strawberry tongue (HP:0031042): Inflamed tongue with hyperplastic (enlarged) fungiform papillae that is said to resemble a strawberry or raspberry. Evidence: TAS. Frequency: Frequent (HP:0040282). (ORPHA:2331)
- Lip fissure (HP:0031250): A severe crack in a lip. A lip fissure may be painful, may bleed and often is a recurring manifestation. Evidence: TAS. Frequency: Frequent (HP:0040282). (ORPHA:2331)
- Abnormality of nail color (HP:0100643): An anomaly of the color of the nail. Evidence: TAS. Frequency: Frequent (HP:0040282). (ORPHA:2331)
- Ptosis (HP:0000508): The upper eyelid margin is positioned 3 mm or more lower than usual and covers the superior portion of the iris (objective); or, the upper lid margin obscures at least part of the pupil (subjective). Evidence: TAS. Frequency: Occasional (HP:0040283). (ORPHA:2331)
- Irritability (HP:0000737): An emotional state characterized by negative feelings of heightened frustration, annoyance, or feeling upset, often triggered by internal factors (e.g., fatigue, hunger, unfulfilled desires) or external factors (e.g., social or environmental challenges). Irritability may be unpredictable, and is accompanied by a lowered threshold for emotional reactivity and observable features (speech, facial expressions, or psychomotor activity). Evidence: TAS. Frequency: Occasional (HP:0040283). (ORPHA:2331)
- Jaundice (HP:0000952): Yellow pigmentation of the skin due to bilirubin, which in turn is the result of increased bilirubin concentration in the bloodstream. Evidence: TAS. Frequency: Occasional (HP:0040283). (ORPHA:2331)
- Cholecystitis (HP:0001082): The presence of inflammatory changes in the gallbladder. Evidence: TAS. Frequency: Occasional (HP:0040283). (ORPHA:2331)
- Meningitis (HP:0001287): Inflammation of the meninges. Evidence: TAS. Frequency: Occasional (HP:0040283). (ORPHA:2331)
- Congestive heart failure (HP:0001635): The presence of an abnormality of cardiac function that is responsible for the failure of the heart to pump blood at a rate that is commensurate with the needs of the tissues or a state in which abnormally elevated filling pressures are required for the heart to do so. Heart failure is frequently related to a defect in myocardial contraction. Evidence: TAS. Frequency: Occasional (HP:0040283). (ORPHA:2331)
- Nausea and vomiting (HP:0002017): Nausea is a commonly encountered symptom that has been defined as an unpleasant painless subjective feeling that one will imminently vomit. Vomiting has been defined as the forceful expulsion of the contents of the stomach, duodenum, or jejunum through the oral cavity. While nausea and vomiting are often thought to exist on a temporal continuum, this is not always the case. There are situations when severe nausea may be present without emesis and less frequently, when emesis may be present without preceding nausea. Evidence: TAS. Frequency: Occasional (HP:0040283). (ORPHA:2331)
- Proteinuria (HP:0000093): Increased levels of protein in the urine. Evidence: TAS. Frequency: Very frequent (HP:0040281). (ORPHA:2331)
- Conjunctivitis (HP:0000509): Inflammation of the conjunctiva. Evidence: TAS. Frequency: Very frequent (HP:0040281). (ORPHA:2331)
- Skin rash (HP:0000988): A red eruption of the skin. Evidence: TAS. Frequency: Very frequent (HP:0040281). (ORPHA:2331)
- Vasculitis (HP:0002633): Inflammation of blood vessel. Evidence: TAS. Frequency: Very frequent (HP:0040281). (ORPHA:2331)
- Cervical lymphadenopathy (HP:0025289): Enlarged lymph nodes in the neck. Evidence: TAS. Frequency: Very frequent (HP:0040281). (ORPHA:2331)
- Palmoplantar erythema (HP:0025493): Redness of the skin of the palm of the hand and the sole of the foot caused by hyperemia of the capillaries in the lower layers of the skin. Evidence: TAS. Frequency: Very frequent (HP:0040281). (ORPHA:2331)
- Recurrent pharyngitis (HP:0100776): Increased susceptibility to pharyngitis, as manifested by recurrent episodes of pharyngeal infection that are unusual in frequency or severity for a healthy individual of the same age. Evidence: TAS. Frequency: Very frequent (HP:0040281). (ORPHA:2331)
- Cheilitis (HP:0100825): Inflammation of the lip. Evidence: TAS. Frequency: Very frequent (HP:0040281). (ORPHA:2331)
- Glossitis (HP:0000206): Inflammation of the tongue. Evidence: TAS. Frequency: Frequent (HP:0040282). (ORPHA:2331)
- Edema (HP:0000969): An abnormal accumulation of fluid beneath the skin, or in one or more cavities of the body. Evidence: TAS. Frequency: Frequent (HP:0040282). (ORPHA:2331)
- Migraine (HP:0002076): Migraine is a chronic neurological disorder characterized by episodic attacks of headache and associated symptoms. Evidence: TAS. Frequency: Occasional (HP:0040283). (ORPHA:2331)
- Arthralgia (HP:0002829): Joint pain. Evidence: TAS. Frequency: Occasional (HP:0040283). (ORPHA:2331)
- Ascending tubular aorta aneurysm (HP:0004970): An abnormal localized widening (dilatation) of the tubular part of the ascending aorta. Evidence: TAS. Frequency: Occasional (HP:0040283). (ORPHA:2331)
- Abnormal pulmonary interstitial morphology (HP:0006530): Abnormality of the lung parenchyma extending to the pulmonary interstitium and leading to diffuse pulmonary fibrosis. Evidence: TAS. Frequency: Occasional (HP:0040283). (ORPHA:2331)
- Cranial nerve paralysis (HP:0006824). Evidence: TAS. Frequency: Occasional (HP:0040283). (ORPHA:2331)
- Double outlet right ventricle with subpulmonary ventricular septal defect without pulmonary stenosis (HP:0011658): A double outlet right ventricle with a ventricular spetal defect (a hole between the two bottom chambers (ventricles) of the heart), that is considered to be closely related to the pulmonary origin. There is not associated pulmonary stenosis, the abnormal narrowing or constriction of the pulmonary artery, in the main pulmonary artery and/or in the left or right pulmonary artery branches. Evidence: TAS. Frequency: Occasional (HP:0040283). (ORPHA:2331)
- Arrhythmia (HP:0011675): Any cardiac rhythm other than the normal sinus rhythm. Such a rhythm may be either of sinus or ectopic origin and either regular or irregular. An arrhythmia may be due to a disturbance in impulse formation or conduction or both. Evidence: TAS. Frequency: Occasional (HP:0040283). (ORPHA:2331)
- Hepatitis (HP:0012115): Inflammation of the liver. Evidence: TAS. Frequency: Occasional (HP:0040283). (ORPHA:2331)
- Myocarditis (HP:0012819): Inflammation of the myocardium. Evidence: TAS. Frequency: Occasional (HP:0040283). (ORPHA:2331)
- Sterile pyuria (HP:0100586): Patients who routinely have greater than 20 leukocytes per microliter, but have abacterial urine, are said to have sterile pyuria. Evidence: TAS. Frequency: Occasional (HP:0040283). (ORPHA:2331)